Phenotypes associated with the disease congenital disorder of glycosylation with defective fucosylation 2 (OMIM:618324):
- Inability to walk (HP:0002540): Incapability to ambulate. Evidence: PCS. Frequency: 2/2. (PMID:30503518)
- Strabismus (HP:0000486): A misalignment of the eyes so that the visual axes deviate from bifoveal fixation. The classification of strabismus may be based on a number of features including the relative position of the eyes, whether the deviation is latent or manifest, intermittent or constant, concomitant or otherwise and according to the age of onset and the relevance of any associated refractive error. Evidence: PCS. Frequency: 1/2. (PMID:30503518)
- Delayed CNS myelination (HP:0002188): Delayed myelination in the central nervous system. Evidence: PCS. Frequency: 1/2. (PMID:30503518)
- Cerebellar atrophy (HP:0001272): Cerebellar atrophy is defined as a cerebellum with initially normal structures, in a posterior fossa with normal size, which displays enlarged fissures (interfolial spaces) in comparison to the foliae secondary to loss of tissue. Cerebellar atrophy implies irreversible loss of tissue and result from an ongoing progressive disease until a final stage is reached or a single injury, e.g. an intoxication or infectious event. Evidence: PCS. Frequency: 1/2. (PMID:30503518)
- Seizure (HP:0001250): A seizure is an intermittent abnormality of nervous system physiology characterized by a transient occurrence of signs and/or symptoms due to abnormal excessive or synchronous neuronal activity in the brain. Evidence: PCS. Frequency: 2/2. (PMID:30503518)
- Hypotonia (HP:0001252): Hypotonia is an abnormally low muscle tone (the amount of tension or resistance to movement in a muscle). Even when relaxed, muscles have a continuous and passive partial contraction which provides some resistance to passive stretching. Hypotonia thus manifests as diminished resistance to passive stretching. Hypotonia is not the same as muscle weakness, although the two conditions can co-exist. Evidence: PCS. Frequency: 2/2. (PMID:30503518)
- Agenesis of corpus callosum (HP:0001274): Absence of the corpus callosum as a result of the failure of the corpus callosum to develop, which can be the result of a failure in any one of the multiple steps of callosal development including cellular proliferation and migration, axonal growth or glial patterning at the midline. Evidence: PCS. Frequency: 1/2. (PMID:30503518)
- Gastroesophageal reflux (HP:0002020): A condition in which the stomach contents leak backwards from the stomach into the esophagus through the lower esophageal sphincter. Evidence: PCS. Frequency: 1/2. (PMID:30503518)
- Severe intellectual disability (HP:0010864): Severe intellectual disability (ID) is defined as a type of ID characterized by severely sub-average adaptive functioning and intellectual functioning, with an intelligence quotient (IQ) the range of 20-34. Evidence: PCS. Frequency: 2/2. (PMID:30503518)
- Nystagmus (HP:0000639): Rhythmic, involuntary oscillations of one or both eyes related to abnormality in fixation, conjugate gaze, or vestibular mechanisms. Evidence: PCS. Frequency: 1/2. (PMID:30503518)
- Cerebral visual impairment (HP:0100704): A form of loss of vision caused by damage to the visual cortex rather than a defect in the eye. Evidence: PCS. Frequency: 1/2. (PMID:30503518)
- Childhood onset (HP:0011463): Onset of disease at the age of between 1 and 5 years. Evidence: PCS. Frequency: 2/2. (PMID:30503518)
- Periventricular leukomalacia (HP:0006970): Periventricular leukomalacia is characterized by diffuse injury of deep cerebral white matter, accompanied in its most severe form by focal necrosis. The neuropathologic hallmarks of PVL are microglial activation and focal and diffuse periventricular depletion of premyelinating oligodendroglia. Evidence: PCS. Frequency: 1/2. (PMID:30503518)
- Premature birth (HP:0001622): The birth of a baby of less than 37 weeks of gestational age. Evidence: PCS. Frequency: 1/2. (PMID:30503518)
- Feeding difficulties (HP:0011968): Impaired ability to eat related to problems gathering food and getting ready to suck, chew, or swallow it. Evidence: PCS. Frequency: 2/2. (PMID:30503518)
- Global developmental delay (HP:0001263): A delay in the achievement of motor or mental milestones in the domains of development of a child, including motor skills, speech and language, cognitive skills, and social and emotional skills. This term should only be used to describe children younger than five years of age. Evidence: PCS. Frequency: 2/2. (PMID:30503518)
- Elevated gamma-glutamyltransferase level (HP:0030948): Increased level of the enzyme gamma-glutamyltransferase (GGT). GGT is mainly present in kidney, liver, and pancreatic cells, but small amounts are present in other tissues. Evidence: PCS. Frequency: 1/2. (PMID:30503518)
- Respiratory insufficiency (HP:0002093). Evidence: PCS. Frequency: 1/2. (PMID:30503518)
- Joint contracture (HP:0034392): A limitation in the passive range of motion of a joint resulting from loss of elasticity in the periarticular tissues owing to structural changes of non-bony tissues, such as muscles, tendons, ligaments, joint capsules or skin. A contracture prevents movement of the associated body part. Evidence: PCS. Frequency: 2/2. (PMID:30503518)
- Appendicular spasticity (HP:0034353): A type of spasticity that affects one or more limbs (arms or legs). Evidence: PCS. Frequency: 1/2. (PMID:30503518)
- Autosomal recessive inheritance (HP:0000007): A mode of inheritance that is observed for traits related to a gene encoded on one of the autosomes (i.e., the human chromosomes 1-22) in which a trait manifests in individuals with two pathogenic alleles, either homozygotes (two copies of the same mutant allele) or compound heterozygotes (whereby each copy of a gene has a distinct mutant allele). Evidence: PCS. (PMID:30503518)
- Epileptic encephalopathy (HP:0200134): A condition in which epileptiform abnormalities are believed to contribute to the progressive disturbance in cerebral function. Epileptic encephalaopathy is characterized by (1) electrographic EEG paroxysmal activity that is often aggressive, (2) seizures that are usually multiform and intractable, (3) cognitive, behavioral and neurological deficits that may be relentless, and (4) sometimes early death. Evidence: PCS. Frequency: 1/2. (PMID:30503518)
- Optic atrophy (HP:0000648): Atrophy of the optic nerve. Optic atrophy results from the death of the retinal ganglion cell axons that comprise the optic nerve and manifesting as a pale optic nerve on fundoscopy. Evidence: PCS. Frequency: 1/2. (PMID:30503518)
- Visual impairment (HP:0000505): Visual impairment (or vision impairment) is vision loss (of a person) to such a degree as to qualify as an additional support need through a significant limitation of visual capability resulting from either disease, trauma, or congenital or degenerative conditions that cannot be corrected by conventional means, such as refractive correction, medication, or surgery. Evidence: PCS. Frequency: 2/2. (PMID:30503518)
- Recurrent respiratory infections (HP:0002205): An increased susceptibility to respiratory infections as manifested by a history of recurrent respiratory infections. Evidence: PCS. Frequency: 1/2. (PMID:30503518)